- Vomiting (HP:0002013): Forceful ejection of the contents of the stomach through the mouth by means of a series of involuntary spasmic contractions. Evidence: IEA. (OMIM:203400)
- Hyperkalemia (HP:0002153): The concentration of potassium(1+) in the blood circulation is above the upper limit of normal. Evidence: IEA. (OMIM:203400)
- Increased circulating renin concentration (HP:0000848): An increased level of renin in the blood. Evidence: IEA. (OMIM:203400)
- Failure to thrive (HP:0001508): Failure to thrive (FTT) refers to a child whose physical growth is substantially below the norm. Evidence: IEA. (OMIM:203400)
- Dehydration (HP:0001944). Evidence: IEA. (OMIM:203400)
- Hyponatremia (HP:0002902): The concentration of sodium in the blood circulation is below the lower limit of normal. Evidence: IEA. (OMIM:203400)
- Autosomal recessive inheritance (HP:0000007): A mode of inheritance that is observed for traits related to a gene encoded on one of the autosomes (i.e., the human chromosomes 1-22) in which a trait manifests in individuals with two pathogenic alleles, either homozygotes (two copies of the same mutant allele) or compound heterozygotes (whereby each copy of a gene has a distinct mutant allele). Evidence: IEA. (OMIM:203400)
- Recurrent fever (HP:0001954): Periodic (episodic or recurrent) bouts of fever. Evidence: IEA. (OMIM:203400)
- Feeding difficulties in infancy (HP:0008872): Impaired feeding performance of an infant as manifested by difficulties such as weak and ineffective sucking, brief bursts of sucking, and falling asleep during sucking. There may be difficulties with chewing or maintaining attention. Evidence: IEA. (OMIM:203400)
- Decreased circulating aldosterone concentration (HP:0004319): Abnormally reduced levels of aldosterone. Evidence: IEA. (OMIM:203400)
- Hypotension (HP:0002615): Low Blood Pressure, vascular hypotension. Evidence: IEA. (OMIM:203400)
- Growth delay (HP:0001510): A deficiency or slowing down of growth pre- and postnatally. Evidence: TAS. (OMIM:203400)
- Renal salt wasting (HP:0000127): A high concentration of one or more electrolytes in the urine in the presence of low serum concentrations of the electrolyte(s). Evidence: IEA. (OMIM:203400)
- Neonatal onset (HP:0003623): Onset of signs or symptoms of disease within the first 28 days of life. Evidence: IEA. (OMIM:203400)
These phenotypes are associated with the disease corticosterone methyloxidase type 1 deficiency (OMIM:203400).